Phenotypes associated with the disease Pentosuria (ORPHA:2843):
- Abnormal circulating enzyme concentration (HP:0011021): Any deviation from the normal concentration of an enzyme in the blood circulation. Evidence: TAS. Frequency: Very frequent (HP:0040281). (ORPHA:2843)
- Abnormal urine carbohydrate level (HP:0031979): Any deviation from the normal concentration of a carbohydrate in the urine. Evidence: TAS. Frequency: Very frequent (HP:0040281). (ORPHA:2843)
- Abnormal circulating carbohydrate concentration (HP:0011013): A deviation from the normal concentration of a carbohydrate in the blood circulation. Evidence: TAS. Frequency: Frequent (HP:0040282). (ORPHA:2843)